Phenotypes associated with the disease neurodevelopmental disorder with brain anomalies and with or without vertebral or cardiac anomalies (OMIM:618731):
- Macrodontia (HP:0001572): Increased size of the teeth, which can be defined as a mesiodistal tooth diameter (width) more than 2 SD above mean for age. Alternatively, an apparently increased maximum width of the tooth. Evidence: PCS. Frequency: 1/5. (PMID:31256877)
- Small nail (HP:0001792): A nail that is diminished in length and width, i.e., underdeveloped nail. Evidence: PCS. Frequency: 1/5. (PMID:31256877)
- Delayed CNS myelination (HP:0002188): Delayed myelination in the central nervous system. Evidence: PCS. Frequency: 1/5. (PMID:31256877)
- Strabismus (HP:0000486): A misalignment of the eyes so that the visual axes deviate from bifoveal fixation. The classification of strabismus may be based on a number of features including the relative position of the eyes, whether the deviation is latent or manifest, intermittent or constant, concomitant or otherwise and according to the age of onset and the relevance of any associated refractive error. Evidence: PCS. Frequency: 1/5. (PMID:31256877)
- Anteverted nares (HP:0000463): Anteriorly-facing nostrils viewed with the head in the Frankfurt horizontal and the eyes of the observer level with the eyes of the subject. This gives the appearance of an upturned nose (upturned nasal tip). Evidence: PCS. Frequency: 1/5. (PMID:31256877)
- Seizure (HP:0001250): A seizure is an intermittent abnormality of nervous system physiology characterized by a transient occurrence of signs and/or symptoms due to abnormal excessive or synchronous neuronal activity in the brain. Evidence: PCS. Frequency: 2/5. (PMID:31256877)
- Infantile spasms (HP:0012469): Infantile spasms represent a subset of "epileptic spasms". Infantile Spasms are epileptic spasms starting in the first year of life (infancy). Evidence: PCS. Frequency: 1/5. (PMID:31256877)
- Nystagmus (HP:0000639): Rhythmic, involuntary oscillations of one or both eyes related to abnormality in fixation, conjugate gaze, or vestibular mechanisms. Evidence: PCS. Frequency: 1/5. (PMID:31256877)
- Blindness (HP:0000618): Blindness is the condition of lacking visual perception defined as a profound reduction in visual perception. On the 6m visual acuity scale, blindness is defined as less than 3/60. On the 20ft visual acuity scale, blindness is defined as less than 20/400. On the decimal visual acuity scale, blindness is defined as less than 0.05. Blindness is typically characterized by a visual field of no greater than 10 degrees in radius around central fixation. Evidence: PCS. Frequency: 2/5. (PMID:31256877)
- Hypertelorism (HP:0000316): Interpupillary distance more than 2 SD above the mean (alternatively, the appearance of an increased interpupillary distance or widely spaced eyes). Evidence: PCS. Frequency: 1/5. (PMID:31256877)
- Downturned corners of mouth (HP:0002714): A morphological abnormality of the mouth in which the angle of the mouth is downturned. The oral commissures are positioned inferior to the midline labial fissure. Evidence: PCS. Frequency: 1/5. (PMID:31256877)
- Protruding ear (HP:0000411): Angle formed by the plane of the ear and the mastoid bone greater than the 97th centile for age (objective); or, outer edge of the helix more than 2 cm from the mastoid at the point of maximum distance (objective). Evidence: PCS. Frequency: 1/5. (PMID:31256877)
- Cervical platyspondyly (HP:0004558): A flattened vertebral body shape with reduced distance between the vertebral endplates affecting the cervical spine. Evidence: PCS. Frequency: 1/5. (PMID:31256877)
- Microcephaly (HP:0000252): Head circumference below 2 standard deviations below the mean for age and gender. Evidence: PCS. Frequency: 1/5. (PMID:31256877)
- Tooth agenesis (HP:0009804): The absence of one or more teeth from the normal series by a failure to develop. Evidence: PCS. Frequency: 1/5. (PMID:31256877)
- Broad neck (HP:0000475): Increased side-to-side width of the neck. Evidence: PCS. Frequency: 1/5. (PMID:31256877)
- Scoliosis (HP:0002650): The presence of an abnormal lateral curvature of the spine. Evidence: PCS. Frequency: 2/5. (PMID:31256877)
- Cerebellar hypoplasia (HP:0001321): Cerebellar hypoplasia is a descriptive term implying a cerebellum with a reduced volume, but a normal shape and is stable over time. Evidence: PCS. Frequency: 1/5. (PMID:31256877)
- Colpocephaly (HP:0030048): Colpocephaly is an anatomic finding in the brain manifested by occipital horns that are disproportionately enlarged in comparison with other parts of the lateral ventricles. Evidence: PCS. Frequency: 1/5. (PMID:31256877)
- Global developmental delay (HP:0001263): A delay in the achievement of motor or mental milestones in the domains of development of a child, including motor skills, speech and language, cognitive skills, and social and emotional skills. This term should only be used to describe children younger than five years of age. Evidence: PCS. Frequency: 5/5. (PMID:31256877)
- Midface retrusion (HP:0011800): Posterior positions and/or vertical shortening of the infraorbital and perialar regions, or increased concavity of the face and/or reduced nasolabial angle. Evidence: PCS. Frequency: 1/5. (PMID:31256877)
- Ptosis (HP:0000508): The upper eyelid margin is positioned 3 mm or more lower than usual and covers the superior portion of the iris (objective); or, the upper lid margin obscures at least part of the pupil (subjective). Evidence: PCS. Frequency: 1/5. (PMID:31256877)
- Ophthalmoplegia (HP:0000602): Paralysis of one or more extraocular muscles that are responsible for eye movements. Evidence: PCS. Frequency: 1/5. (PMID:31256877)
- Autosomal recessive inheritance (HP:0000007): A mode of inheritance that is observed for traits related to a gene encoded on one of the autosomes (i.e., the human chromosomes 1-22) in which a trait manifests in individuals with two pathogenic alleles, either homozygotes (two copies of the same mutant allele) or compound heterozygotes (whereby each copy of a gene has a distinct mutant allele). Evidence: PCS. (PMID:31256877)
- Pointed chin (HP:0000307): A marked tapering of the lower face to the chin. Evidence: PCS. Frequency: 1/5. (PMID:31256877)
- Plagiocephaly (HP:0001357): Asymmetric head shape, which is usually a combination of unilateral occipital flattening with ipsilateral frontal prominence, leading to rhomboid cranial shape. Evidence: PCS. Frequency: 2/5. (PMID:31256877)
- Short philtrum (HP:0000322): Distance between nasal base and midline upper lip vermilion border more than 2 SD below the mean. Alternatively, an apparently decreased distance between nasal base and midline upper lip vermilion border. Evidence: PCS. Frequency: 1/5. (PMID:31256877)
- Polymicrogyria (HP:0002126): Polymicrogyria is a congenital malformation of the cerebral cortex characterized by abnormal cortical layering (lamination) and an excessive number of small gyri (folds). Evidence: PCS. Frequency: 2/5. (PMID:31256877)
- Facial asymmetry (HP:0000324): An abnormal difference between the left and right sides of the face. Evidence: PCS. Frequency: 1/5. (PMID:31256877)